Phenotypes associated with the disease brain small vessel disease 2B, autosomal recessive (OMIM:621414):
- Poor head control (HP:0002421): Difficulty to maintain correct position of the head while standing or sitting. Infant head lag is observed when the head seems to flop around or lags posteriorly behind the trunk. Several articles have maintained that head lag should be absent by age 3 to 4 months. Evidence: PCS. Frequency: 1/1. (PMID:33912663)
- Inability to walk (HP:0002540): Incapability to ambulate. Evidence: PCS. Frequency: 1/1. (PMID:33912663)
- Strabismus (HP:0000486): A misalignment of the eyes so that the visual axes deviate from bifoveal fixation. The classification of strabismus may be based on a number of features including the relative position of the eyes, whether the deviation is latent or manifest, intermittent or constant, concomitant or otherwise and according to the age of onset and the relevance of any associated refractive error. Evidence: PCS. Frequency: 1/1. (PMID:36603335)
- Cerebral cortical atrophy (HP:0002120): Atrophy of the cortex of the cerebrum. Evidence: PCS. Frequency: 1/1. (PMID:33912663)
- Hypotonia (HP:0001252): Hypotonia is an abnormally low muscle tone (the amount of tension or resistance to movement in a muscle). Even when relaxed, muscles have a continuous and passive partial contraction which provides some resistance to passive stretching. Hypotonia thus manifests as diminished resistance to passive stretching. Hypotonia is not the same as muscle weakness, although the two conditions can co-exist. Evidence: PCS. Frequency: 1/1. (PMID:36603335)
- Infantile onset (HP:0003593): Onset of signs or symptoms of disease between 28 days to one year of life. Evidence: PCS. Frequency: 3/3. (PMID:36603335;PMID:33912663)
- Abnormal circulating creatine kinase activity (HP:0040081): Any deviation from the normal activity of creatine kinase in the blood circulation. Evidence: PCS. Frequency: 0/1. (PMID:36603335)
- Nystagmus (HP:0000639): Rhythmic, involuntary oscillations of one or both eyes related to abnormality in fixation, conjugate gaze, or vestibular mechanisms. Evidence: PCS. Frequency: 1/1. (PMID:33912663)
- Cerebral visual impairment (HP:0100704): A form of loss of vision caused by damage to the visual cortex rather than a defect in the eye. Evidence: PCS. Frequency: 1/1. (PMID:33912663)
- Absent speech (HP:0001344): Complete lack of development of speech and language abilities. Evidence: PCS. Frequency: 2/2. (PMID:33912663)
- Delayed speech and language development (HP:0000750): A degree of language development that is significantly below the norm for a child of a specified age. Evidence: PCS. Frequency: 1/1. (PMID:36603335)
- Delayed ability to walk (HP:0031936): A failure to achieve the ability to walk at an appropriate developmental stage. Most children learn to walk in a series of stages, and learn to walk short distances independently between 12 and 15 months. Evidence: PCS. Frequency: 1/1. (PMID:33912663)
- Colpocephaly (HP:0030048): Colpocephaly is an anatomic finding in the brain manifested by occipital horns that are disproportionately enlarged in comparison with other parts of the lateral ventricles. Evidence: PCS. Frequency: 2/2. (PMID:36603335;PMID:33912663)
- Generalized-onset seizure (HP:0002197): A generalized-onset seizure is a type of seizure originating at some point within, and rapidly engaging, bilaterally distributed networks. The networks may include cortical and subcortical structures but not necessarily the entire cortex. Evidence: PCS. Frequency: 1/1. (PMID:36603335)
- Porencephalic cyst (HP:0002132): A cavity within the cerebral hemisphere, filled with cerebrospinal fluid, that communicates directly with the ventricular system. Evidence: PCS. Frequency: 1/2. (PMID:36603335;PMID:33912663)
- Global developmental delay (HP:0001263): A delay in the achievement of motor or mental milestones in the domains of development of a child, including motor skills, speech and language, cognitive skills, and social and emotional skills. This term should only be used to describe children younger than five years of age. Evidence: PCS. Frequency: 1/1. (PMID:33912663)
- Tetraparesis (HP:0002273): Weakness of all four limbs. Evidence: PCS. Frequency: 1/1. (PMID:33912663)
- Cerebral palsy (HP:0100021): Cerebral palsy describes a group of permanent disorders of the development of movement and posture, causing activity limitation, that are attributed to nonprogressive disturbances that occurred in the developing fetal or infant brain. The motor disorders of cerebral palsy are often accompanied by disturbances of sensation, perception, cognition, communication, and behavior, by epilepsy, and by secondary musculoskeletal problems. Evidence: PCS. Frequency: 2/2. (PMID:33912663)
- EEG with polyspike wave complexes (HP:0002392): The presence of complexes of repetitive spikes and waves in EEG. Evidence: PCS. Frequency: 1/1. (PMID:36603335)
- Profound global developmental delay (HP:0012736): A profound delay in the achievement of motor or mental milestones in the domains of development of a child. Evidence: PCS. Frequency: 1/1. (PMID:33912663)
- Ophthalmoplegia (HP:0000602): Paralysis of one or more extraocular muscles that are responsible for eye movements. Evidence: PCS. Frequency: 1/1. (PMID:33912663)
- Autosomal recessive inheritance (HP:0000007): A mode of inheritance that is observed for traits related to a gene encoded on one of the autosomes (i.e., the human chromosomes 1-22) in which a trait manifests in individuals with two pathogenic alleles, either homozygotes (two copies of the same mutant allele) or compound heterozygotes (whereby each copy of a gene has a distinct mutant allele). Evidence: PCS. (PMID:33912663)
- Intracranial calcification (HP:0430048): Intracranial calcifications refer to calcifications within the brain parenchyma or vasculature. The five major components of the brain comprise the cerebrum, cerebellum, brain stem, pituitary gland, and hypothalamus. Evidence: PCS. Frequency: 1/1. (PMID:36603335)
- Spasticity (HP:0001257): A motor disorder characterized by a velocity-dependent increase in tonic stretch reflexes with increased muscle tone, exaggerated (hyperexcitable) tendon reflexes. Evidence: PCS. Frequency: 2/2. (PMID:33912663)
- Focal-onset seizure (HP:0007359): A focal-onset seizure is a type of seizure originating within networks limited to one hemisphere. They may be discretely localized or more widely distributed, and may originate in subcortical structures. Evidence: PCS. Frequency: 2/2. (PMID:33912663)
- Tetraplegia (HP:0002445): Paralysis of all four limbs, and trunk of the body below the level of an associated injury to the spinal cord. The etiology of quadriplegia is similar to that of paraplegia except that the lesion is in the cervical spinal cord rather than in the thoracic or lumbar segments of the spinal cord. Evidence: PCS. Frequency: 1/1. (PMID:33912663)